Phenotypes associated with the disease isolated cleft palate (OMIM:119540):
- Cleft palate (HP:0000175): Cleft palate is a developmental defect of the palate resulting from a failure of fusion of the palatine processes and manifesting as a separation of the roof of the mouth (soft and hard palate). Evidence: TAS. (OMIM:119540)
- Increased overbite (HP:0011094): Maxillary teeth cover the mandibular teeth when biting to an increased degree. The feature is defined as a vertical overlap of the maxillary incisors over the mandibular incisors that exceeds 2 mm. Evidence: TAS. (OMIM:119540)
- Seizure (HP:0001250): A seizure is an intermittent abnormality of nervous system physiology characterized by a transient occurrence of signs and/or symptoms due to abnormal excessive or synchronous neuronal activity in the brain. Evidence: TAS. (OMIM:119540)
- Profound intellectual disability (HP:0002187): Profound intellectual disability (ID) is defined as a type of ID characterized by profoundly sub-average adaptive functioning and intellectual functioning, with an intelligence quotient (IQ) below 20. Evidence: TAS. (OMIM:119540)
- Anterior open-bite malocclusion (HP:0009102): Anterior open bite is a malocclusion characterized by a gap between the anterior teeth (incisors), that is, by a deficiency in the normal vertical overlap between antagonist incisal edges when the posterior teeth are in occlusion. Evidence: TAS. (OMIM:119540)
- Gingival overgrowth (HP:0000212): Hyperplasia of the gingiva (that is, a thickening of the soft tissue overlying the alveolar ridge. The degree of thickening ranges from involvement of the interdental papillae alone to gingival overgrowth covering the entire tooth crown. Evidence: TAS. (OMIM:119540)
- Autosomal dominant inheritance (HP:0000006): A mode of inheritance that is observed for traits related to a gene encoded on one of the autosomes (i.e., the human chromosomes 1-22) in which a trait manifests in heterozygotes. In the context of medical genetics, an autosomal dominant disorder is caused when a single copy of the mutant allele is present. Males and females are affected equally, and can both transmit the disorder with a risk of 50% for each child of inheriting the mutant allele. Evidence: IEA. (OMIM:119540)
- Micrognathia (HP:0000347): Developmental hypoplasia of the mandible. Evidence: TAS. (OMIM:119540)